- Urinary retention (HP:0000016): Inability to completely empty the urinary bladder during the process of urination. Evidence: TAS. Frequency: Frequent (HP:0040282). (ORPHA:254509)
- Xerostomia (HP:0000217): Dryness of the mouth due to salivary gland dysfunction. Evidence: TAS. Frequency: Very frequent (HP:0040281). (ORPHA:254509)
- Ptosis (HP:0000508): The upper eyelid margin is positioned 3 mm or more lower than usual and covers the superior portion of the iris (objective); or, the upper lid margin obscures at least part of the pupil (subjective). Evidence: TAS. Frequency: Very frequent (HP:0040281). (ORPHA:254509)
- Orthostatic hypotension (HP:0001278): A form of hypotension characterized by a sudden fall in blood pressure that occurs when a person assumes a standing position. Evidence: TAS. Frequency: Very frequent (HP:0040281). (ORPHA:254509)
- Muscle weakness (HP:0001324): Reduced strength of muscles. Evidence: TAS. Frequency: Very frequent (HP:0040281). (ORPHA:254509)
- Dysphagia (HP:0002015): Difficulty in swallowing. Evidence: TAS. Frequency: Very frequent (HP:0040281). (ORPHA:254509)
- Constipation (HP:0002019): Infrequent or difficult evacuation of feces. Evidence: TAS. Frequency: Frequent (HP:0040282). (ORPHA:254509)
- Dyspnea (HP:0002094): Difficult or labored breathing. Dyspnea is a subjective feeling only the patient can rate, e.g., on a Borg scale. Evidence: TAS. Frequency: Frequent (HP:0040282). (ORPHA:254509)
- Diaphragmatic paralysis (HP:0006597): The presence of a paralyzed diaphragm. Evidence: TAS. Frequency: Very frequent (HP:0040281). (ORPHA:254509)
- Cranial nerve paralysis (HP:0006824). Evidence: TAS. Frequency: Very frequent (HP:0040281). (ORPHA:254509)
- Mydriasis (HP:0011499): Abnormal dilatation of the iris. Evidence: TAS. Frequency: Very frequent (HP:0040281). (ORPHA:254509)
- Fatigue (HP:0012378): A subjective feeling of tiredness characterized by a lack of energy and motivation. Evidence: TAS. Frequency: Very frequent (HP:0040281). (ORPHA:254509)
- Cerebral palsy (HP:0100021): Cerebral palsy describes a group of permanent disorders of the development of movement and posture, causing activity limitation, that are attributed to nonprogressive disturbances that occurred in the developing fetal or infant brain. The motor disorders of cerebral palsy are often accompanied by disturbances of sensation, perception, cognition, communication, and behavior, by epilepsy, and by secondary musculoskeletal problems. Evidence: TAS. Frequency: Very frequent (HP:0040281). (ORPHA:254509)
These phenotypes are associated with the disease Iatrogenic botulism (ORPHA:254509).